Phenotypes associated with the disease autosomal dominant nonsyndromic hearing loss 24 (OMIM:606282):
- Hearing impairment (HP:0000365): A decreased magnitude of the sensory perception of sound. Evidence: TAS. (OMIM:606282)
- Autosomal dominant inheritance (HP:0000006): A mode of inheritance that is observed for traits related to a gene encoded on one of the autosomes (i.e., the human chromosomes 1-22) in which a trait manifests in heterozygotes. In the context of medical genetics, an autosomal dominant disorder is caused when a single copy of the mutant allele is present. Males and females are affected equally, and can both transmit the disorder with a risk of 50% for each child of inheriting the mutant allele. Evidence: TAS. (OMIM:606282)